- Fructose intolerance (HP:0005973): Reduced intestinal absorption of fructose. Breath testing after ingestion of fructose has been widely adopted as a standard method of identifying fructose malabsorption and intolerance. A dose of 25 g of fructose dissolved in a 10% solution is generally accepted as the appropriate dose of fructose for clinical use of H2 and CH4 breath testing. High levels of hydrogen in exhaled breath subsequent hours indicate fructose intolerance. Presence of malabsorption and reproduction of symptoms during a breath test provides the best objective evidence and symptom correlation for fructose intolerance. Evidence: IEA. (OMIM:229500)
- Seizure (HP:0001250): A seizure is an intermittent abnormality of nervous system physiology characterized by a transient occurrence of signs and/or symptoms due to abnormal excessive or synchronous neuronal activity in the brain. Evidence: IEA. (OMIM:229500)
- Galactose intolerance (HP:0004919). Evidence: TAS. (OMIM:229500)
- Autosomal recessive inheritance (HP:0000007): A mode of inheritance that is observed for traits related to a gene encoded on one of the autosomes (i.e., the human chromosomes 1-22) in which a trait manifests in individuals with two pathogenic alleles, either homozygotes (two copies of the same mutant allele) or compound heterozygotes (whereby each copy of a gene has a distinct mutant allele). Evidence: IEA. (OMIM:229500)
- Hypoglycemia (HP:0001943): A decreased concentration of glucose in the blood. Evidence: IEA. (OMIM:229500)
These phenotypes are associated with the disease fructose and galactose intolerance (OMIM:229500).